Phenotypes associated with the disease atrial fibrillation, familial, 2 (OMIM:608988):
- Adult onset (HP:0003581): Onset of disease manifestations in adulthood, defined here as at the age of 16 years or later. Evidence: PCS. (PMID:12782570)
- Atrial fibrillation (HP:0005110): An atrial arrhythmia characterized by disorganized atrial activity without discrete P waves on the surface EKG, but instead by an undulating baseline or more sharply circumscribed atrial deflections of varying amplitude an frequency ranging from 350 to 600 per minute. Evidence: PCS. (PMID:12782570)
- Autosomal dominant inheritance (HP:0000006): A mode of inheritance that is observed for traits related to a gene encoded on one of the autosomes (i.e., the human chromosomes 1-22) in which a trait manifests in heterozygotes. In the context of medical genetics, an autosomal dominant disorder is caused when a single copy of the mutant allele is present. Males and females are affected equally, and can both transmit the disorder with a risk of 50% for each child of inheriting the mutant allele. Evidence: PCS. (PMID:12782570)